Phenotypes associated with the disease OUABAIN RESISTANCE (OMIM:311350, an entry in Online Mendelian Inheritance in Man):
- X-linked inheritance (HP:0001417, a Human Phenotype Ontology term): A mode of inheritance that is observed for traits related to a gene encoded on the X chromosome. Evidence: IEA. (OMIM:311350)